- Sensorineural hearing impairment (HP:0000407): A type of hearing impairment in one or both ears related to an abnormal functionality of the cochlear nerve. Evidence: TAS. Onset: Infantile onset (HP:0003593). (OMIM:609006)
- Autosomal recessive inheritance (HP:0000007): A mode of inheritance that is observed for traits related to a gene encoded on one of the autosomes (i.e., the human chromosomes 1-22) in which a trait manifests in individuals with two pathogenic alleles, either homozygotes (two copies of the same mutant allele) or compound heterozygotes (whereby each copy of a gene has a distinct mutant allele). Evidence: TAS. (OMIM:609006)
- Vestibular areflexia (HP:0008568): Vestibular areflexia can be measured as the absence of the caloric nystagmus response in electronystagmography. Evidence: TAS. (OMIM:609006)
These phenotypes are associated with the disease autosomal recessive nonsyndromic hearing loss 36 (OMIM:609006).